- Abnormality of the dentition (HP:0000164): Any abnormality of the teeth. Evidence: TAS. Frequency: Very frequent (HP:0040281). (ORPHA:2287)
- Advanced eruption of teeth (HP:0006288): Premature tooth eruption, which can be defined as tooth eruption more than 2 SD earlier than the mean eruption age. Evidence: TAS. Frequency: Very frequent (HP:0040281). (ORPHA:2287)
These phenotypes are associated with the disease Fused mandibular incisors (ORPHA:2287).